- Skin rash (HP:0000988): A red eruption of the skin. Evidence: TAS. Frequency: Very frequent (HP:0040281). (ORPHA:85414)
- Arthritis (HP:0001369): Inflammation of a joint. Evidence: TAS. Frequency: Very frequent (HP:0040281). (ORPHA:85414)
- Joint swelling (HP:0001386). Evidence: TAS. Frequency: Very frequent (HP:0040281). (ORPHA:85414)
- Fever (HP:0001945): Body temperature elevated above the normal range. Evidence: TAS. Frequency: Very frequent (HP:0040281). (ORPHA:85414)
- Arthralgia (HP:0002829): Joint pain. Evidence: TAS. Frequency: Very frequent (HP:0040281). (ORPHA:85414)
- Autoimmunity (HP:0002960): The occurrence of an immune reaction against the organism's own cells or tissues. Evidence: TAS. Frequency: Very frequent (HP:0040281). (ORPHA:85414)
- Elevated erythrocyte sedimentation rate (HP:0003565): An increased erythrocyte sedimentation rate (ESR). The ESR is a test that measures the distance that erythrocytes have fallen after one hour in a vertical column of anticoagulated blood under the influence of gravity. The ESR is a nonspecific finding. An elevation may indicate inflammation or may be caused by any condition that elevates fibrinogen. Evidence: TAS. Frequency: Very frequent (HP:0040281). (ORPHA:85414)
- Juvenile rheumatoid arthritis (HP:0005681). Evidence: TAS. Frequency: Very frequent (HP:0040281). (ORPHA:85414)
- Elevated circulating C-reactive protein concentration (HP:0011227): The concentration of C-reactive protein in the blood circulation is above the upper limit of normal. Evidence: TAS. Frequency: Very frequent (HP:0040281). (ORPHA:85414)
- Lymphadenopathy (HP:0002716): Enlargement (swelling) of a lymph node. Evidence: TAS. Frequency: Frequent (HP:0040282). (ORPHA:85414)
- Glomerulonephritis (HP:0000099): Inflammation of the renal glomeruli. Evidence: TAS. Frequency: Occasional (HP:0040283). (ORPHA:85414)
- Osteopenia (HP:0000938): Osteopenia is a term to define bone density that is not normal but also not as low as osteoporosis. By definition from the World Health Organization osteopenia is defined by bone densitometry as a T score -1 to -2.5. Evidence: TAS. Frequency: Occasional (HP:0040283). (ORPHA:85414)
- Growth delay (HP:0001510): A deficiency or slowing down of growth pre- and postnatally. Evidence: TAS. Frequency: Occasional (HP:0040283). (ORPHA:85414)
- Pericarditis (HP:0001701): Inflammation of the sac-like covering around the heart (pericardium). Evidence: TAS. Frequency: Occasional (HP:0040283). (ORPHA:85414)
- Splenomegaly (HP:0001744): Abnormal increased size of the spleen. Evidence: TAS. Frequency: Occasional (HP:0040283). (ORPHA:85414)
- Abdominal pain (HP:0002027): An unpleasant sensation characterized by physical discomfort (such as pricking, throbbing, or aching) and perceived to originate in the abdomen. Evidence: TAS. Frequency: Occasional (HP:0040283). (ORPHA:85414)
- Pleural effusion (HP:0002202): The presence of an excessive amount of fluid in the pleural cavity. Evidence: TAS. Frequency: Occasional (HP:0040283). (ORPHA:85414)
- Hepatomegaly (HP:0002240): Abnormally increased size of the liver. Evidence: TAS. Frequency: Occasional (HP:0040283). (ORPHA:85414)
- Increased circulating ferritin concentration (HP:0003281): Increased concentration of ferritin in the blood circulation. Evidence: TAS. Frequency: Occasional (HP:0040283). (ORPHA:85414)
- Elevated pulmonary artery pressure (HP:0004890): An abnormally elevated blood pressure in the circulation of the pulmonary artery. Evidence: TAS. Frequency: Occasional (HP:0040283). (ORPHA:85414)
- Anterior uveitis (HP:0012122): Inflammation of the uveal tract in which the primary site of inflammation is the anterior chamber. Evidence: TAS. Frequency: Occasional (HP:0040283). (ORPHA:85414)
- Non-infectious meningitis (HP:0033430): Inflammation of the layers of tissue that cover the brain and spinal cord (meninges) and of the fluid-filled space between the meninges (subarachnoid space) when it is caused by disorders that are not infections or by drugs or vaccines. Evidence: TAS. Frequency: Occasional (HP:0040283). (ORPHA:85414)
These phenotypes are associated with the disease Systemic-onset juvenile idiopathic arthritis (ORPHA:85414).